- Hyperthyroidism (HP:0000836): An abnormality of thyroid physiology characterized by excessive secretion of the thyroid hormones thyroxine (i.e., T4) and/or 3,3',5-triiodo-L-thyronine zwitterion (i.e., triiodothyronine or T3). Evidence: TAS. Frequency: Occasional (HP:0040283). (ORPHA:99927)
- Anemia (HP:0001903): A reduction in erythrocytes volume or hemoglobin concentration. Evidence: TAS. Frequency: Very frequent (HP:0040281). (ORPHA:99927)
- Nausea and vomiting (HP:0002017): Nausea is a commonly encountered symptom that has been defined as an unpleasant painless subjective feeling that one will imminently vomit. Vomiting has been defined as the forceful expulsion of the contents of the stomach, duodenum, or jejunum through the oral cavity. While nausea and vomiting are often thought to exist on a temporal continuum, this is not always the case. There are situations when severe nausea may be present without emesis and less frequently, when emesis may be present without preceding nausea. Evidence: TAS. Frequency: Very frequent (HP:0040281). (ORPHA:99927)
- Miscarriage (HP:0005268): A pregnancy that ends at a stage in which the fetus is incapable of surviving on its own, defined as the spontaneous loss of a fetus before the 22th week of pregnancy. Evidence: TAS. Frequency: Very frequent (HP:0040281). (ORPHA:99927)
- Preeclampsia (HP:0100602): Pregnancy-induced hypertension in association with significant amounts of protein in the urine. Evidence: TAS. Frequency: Very frequent (HP:0040281). (ORPHA:99927)
- Enlarged uterus (HP:0100878). Evidence: TAS. Frequency: Very frequent (HP:0040281). (ORPHA:99927)
- Menometrorrhagia (HP:0400008): Prolonged/excessive menses and bleeding at irregular intervals. Evidence: TAS. Frequency: Very frequent (HP:0040281). (ORPHA:99927)
These phenotypes are associated with the disease Hydatidiform mole (ORPHA:99927).